Phenotypes associated with the disease Delayed membranous cranial ossification (ORPHA:3034):
- Prominent occiput (HP:0000269): Increased convexity of the occiput (posterior part of the skull). Evidence: TAS. Frequency: Frequent (HP:0040282). (ORPHA:3034)
- Hypertelorism (HP:0000316): Interpupillary distance more than 2 SD above the mean (alternatively, the appearance of an increased interpupillary distance or widely spaced eyes). Evidence: TAS. Frequency: Very frequent (HP:0040281). (ORPHA:3034)
- Depressed nasal ridge (HP:0000457): Lack of prominence of the nose resulting from a posteriorly-placed nasal ridge. Evidence: TAS. Frequency: Very frequent (HP:0040281). (ORPHA:3034)
- Upslanted palpebral fissure (HP:0000582): The palpebral fissure inclination is more than two standard deviations above the mean for age (objective); or, the inclination of the palpebral fissure is greater than typical for age. Evidence: TAS. Frequency: Very frequent (HP:0040281). (ORPHA:3034)
- Frontal bossing (HP:0002007): Bilateral bulging of the lateral frontal bone prominences with relative sparing of the midline. Evidence: TAS. Frequency: Very frequent (HP:0040281). (ORPHA:3034)
- Decreased skull ossification (HP:0004331): A reduction in the magnitude or amount of ossification of the skull. Evidence: TAS. Frequency: Very frequent (HP:0040281). (ORPHA:3034)
- Midface retrusion (HP:0011800): Posterior positions and/or vertical shortening of the infraorbital and perialar regions, or increased concavity of the face and/or reduced nasolabial angle. Evidence: TAS. Frequency: Very frequent (HP:0040281). (ORPHA:3034)